Phenotypes associated with the disease Panner disease (ORPHA:97336):
- Abnormal humerus morphology (HP:0031095): Any structural anomaly of the structure of the humerus (i.e., upper arm bone). Evidence: TAS. Frequency: Frequent (HP:0040282). (ORPHA:97336)
- Abnormality of upper limb joint (HP:0009810). Evidence: TAS. Frequency: Very frequent (HP:0040281). (ORPHA:97336)
- Osteochondrosis (HP:0040188): Abnormal growth ossification centers in children. Initially a degeneration/ necrosis followed by regeneration or recalcification. Evidence: TAS. Frequency: Very frequent (HP:0040281). (ORPHA:97336)
- Limited elbow extension (HP:0001377): Limited ability to straighten the arm at the elbow joint. Evidence: TAS. Frequency: Frequent (HP:0040282). (ORPHA:97336)
- Joint swelling (HP:0001386). Evidence: TAS. Frequency: Frequent (HP:0040282). (ORPHA:97336)
- Limited elbow movement (HP:0002996). Evidence: TAS. Frequency: Frequent (HP:0040282). (ORPHA:97336)
- Elbow pain (HP:0030835): An unpleasant sensation characterized by physical discomfort (such as pricking, throbbing, or aching) localized to the elbow. Evidence: TAS. Frequency: Frequent (HP:0040282). (ORPHA:97336)
- Abnormality of blood and blood-forming tissues (HP:0001871): An abnormality of the hematopoietic system. Evidence: TAS. Frequency: Occasional (HP:0040283). (ORPHA:97336)
- Irregular articular surfaces of the elbow joints (HP:0003945). Evidence: TAS. Frequency: Occasional (HP:0040283). (ORPHA:97336)
- Stiff elbow (HP:0025259): A sensation of tightness in the elbow joint when attempting to move it, especially after a period of inactivity. Evidence: TAS. Frequency: Occasional (HP:0040283). (ORPHA:97336)
- Large elbow (HP:0030865): Abnormal increased size of the elbow joint. Evidence: TAS. Frequency: Occasional (HP:0040283). (ORPHA:97336)